Phenotypes associated with the disease Moderate hemophilia A (ORPHA:169805):
- Intraventricular hemorrhage (HP:0030746): Bleeding into the ventricles of the brain. Evidence: TAS. Frequency: Very rare (HP:0040284). (ORPHA:169805)
- Epidural hemorrhage (HP:0100310): Hemorrhage occurring between the dura mater and the skull. Evidence: TAS. Frequency: Very rare (HP:0040284). (ORPHA:169805)
- Abnormal bleeding (HP:0001892): An abnormal susceptibility to bleeding, often referred to as a bleeding diathesis. A bleeding diathesis may be related to vascular, platelet and coagulation defects. Evidence: TAS. Frequency: Very frequent (HP:0040281). (ORPHA:169805)
- Reduced factor VIII activity (HP:0003125): Reduced activity of coagulation factor VIII. Factor VIII (fVIII) is a cofactor in the intrinsic clotting cascade that is activated to fVIIIa in the presence of minute quantities of thrombin. fVIIIa acts as a receptor, for factors IXa and X. Evidence: TAS. Frequency: Very frequent (HP:0040281). (ORPHA:169805)
- Prolonged partial thromboplastin time (HP:0003645): Increased time to coagulation in the partial thromboplastin time (PTT) test, a measure of the intrinsic and common coagulation pathways. Phospholipid, and activator, and calcium are mixed into an anticoagulated plasma sample, and the time is measured until a thrombus forms. Evidence: TAS. Frequency: Very frequent (HP:0040281). (ORPHA:169805)
- Gingival bleeding (HP:0000225): Hemorrhage affecting the gingiva. Evidence: TAS. Frequency: Frequent (HP:0040282). (ORPHA:169805)
- Subcutaneous hemorrhage (HP:0001933): This term refers to an abnormally increased susceptibility to bruising (purpura, petechiae, or ecchymoses). Evidence: TAS. Frequency: Frequent (HP:0040282). (ORPHA:169805)
- Arthralgia (HP:0002829): Joint pain. Evidence: TAS. Frequency: Frequent (HP:0040282). (ORPHA:169805)
- Joint hemorrhage (HP:0005261): Hemorrhage occurring within a joint. Evidence: TAS. Frequency: Frequent (HP:0040282). (ORPHA:169805)
- Bleeding with minor or no trauma (HP:0011889): Significant bleeding or hemorrhage without significant precipitating factor. Evidence: TAS. Frequency: Frequent (HP:0040282). (ORPHA:169805)
- Intramuscular hematoma (HP:0012233): Blood clot formed within muscle tissue following leakage of blood into the tissue. Evidence: TAS. Frequency: Frequent (HP:0040282). (ORPHA:169805)
- Hematuria (HP:0000790): The presence of blood in the urine. Hematuria may be gross hematuria (visible to the naked eye) or microscopic hematuria (detected by dipstick or microscopic examination of the urine). Evidence: TAS. Frequency: Occasional (HP:0040283). (ORPHA:169805)
- Limitation of joint mobility (HP:0001376): A reduction in the freedom of movement of one or more joints. Evidence: TAS. Frequency: Occasional (HP:0040283). (ORPHA:169805)
- Joint swelling (HP:0001386). Evidence: TAS. Frequency: Occasional (HP:0040283). (ORPHA:169805)
- Intracranial hemorrhage (HP:0002170): Hemorrhage occurring within the skull. Evidence: TAS. Frequency: Occasional (HP:0040283). (ORPHA:169805)
- Gastrointestinal hemorrhage (HP:0002239): Hemorrhage affecting the gastrointestinal tract. Evidence: TAS. Frequency: Occasional (HP:0040283). (ORPHA:169805)
- Headache (HP:0002315): Cephalgia, or pain sensed in various parts of the head, not confined to the area of distribution of any nerve. Evidence: TAS. Frequency: Occasional (HP:0040283). (ORPHA:169805)
- Arthropathy (HP:0003040). Evidence: TAS. Frequency: Occasional (HP:0040283). (ORPHA:169805)
- Prolonged bleeding after surgery (HP:0004846): Bleeding that persists longer than the normal time following a surgical procedure. Evidence: TAS. Frequency: Occasional (HP:0040283). (ORPHA:169805)
- Prolonged bleeding after dental extraction (HP:0006298): Prolonged bleeding post dental extraction sufficient to require medical intervention. Evidence: TAS. Frequency: Occasional (HP:0040283). (ORPHA:169805)
- Subdural hemorrhage (HP:0100309): Hemorrhage occurring between the dura mater and the arachnoid mater. Evidence: TAS. Frequency: Occasional (HP:0040283). (ORPHA:169805)
- Synovitis (HP:0100769). Evidence: TAS. Frequency: Occasional (HP:0040283). (ORPHA:169805)
- Cartilage destruction (HP:0100773). Evidence: TAS. Frequency: Occasional (HP:0040283). (ORPHA:169805)
- Seizure (HP:0001250): A seizure is an intermittent abnormality of nervous system physiology characterized by a transient occurrence of signs and/or symptoms due to abnormal excessive or synchronous neuronal activity in the brain. Evidence: TAS. Frequency: Very rare (HP:0040284). (ORPHA:169805)
- Hip contracture (HP:0003273): Lack of full passive range of motion (restrictions in flexion, extension, or other movements) of the hip joint resulting from structural changes of non-bony tissues, such as muscles, tendons, ligaments, joint capsules and/or skin. Evidence: TAS. Frequency: Very rare (HP:0040284). (ORPHA:169805)
- Spontaneous hematomas (HP:0007420): Spontaneous development of hematomas (hematoma) or bruises without significant trauma. Evidence: TAS. Frequency: Very rare (HP:0040284). (ORPHA:169805)